- Transient myeloproliferative syndrome (HP:0005534, a Human Phenotype Ontology term): A unique clonal neoplastic disorder that is linked to trisomy 21, is restricted to neonatal period, and spontaneously regresses. It often has characteristics of megakaryocytic lineage and is associated with GATA1 mutations in myeloblasts. Evidence: IEA. (OMIM:159595)
- Increased total leukocyte count (HP:0001974, a Human Phenotype Ontology term): An abnormal increase in the number of leukocytes in the blood. Evidence: IEA. (OMIM:159595)
These phenotypes are associated with the disease transient myeloproliferative syndrome (OMIM:159595, an entry in Online Mendelian Inheritance in Man).